- Delayed speech and language development (HP:0000750): A degree of language development that is significantly below the norm for a child of a specified age. Evidence: PCS. Frequency: 2/11. (PMID:29656860)
- Seizure (HP:0001250): A seizure is an intermittent abnormality of nervous system physiology characterized by a transient occurrence of signs and/or symptoms due to abnormal excessive or synchronous neuronal activity in the brain. Evidence: PCS. Frequency: 6/26. (PMID:29656860)
- Feeding difficulties (HP:0011968): Impaired ability to eat related to problems gathering food and getting ready to suck, chew, or swallow it. Evidence: PCS. Frequency: 8/14. (PMID:29656860)
- Autistic behavior (HP:0000729): Persistent deficits in social interaction and communication and interaction as well as a markedly restricted repertoire of activity and interest as well as repetitive patterns of behavior. Evidence: PCS. Frequency: 24/27. (PMID:29656860)
- Global developmental delay (HP:0001263): A delay in the achievement of motor or mental milestones in the domains of development of a child, including motor skills, speech and language, cognitive skills, and social and emotional skills. This term should only be used to describe children younger than five years of age. Evidence: PCS. (PMID:29656860)
- Motor stereotypy (HP:0000733): Use of the same abnormal action in response to certain triggers or at random. They may be used as a way to regulate one's internal state but must otherwise have no apparent functional purpose. Evidence: PCS. Frequency: 1/32. (PMID:29656860)
- Motor delay (HP:0001270): A type of Developmental delay characterized by a delay in acquiring motor skills. Evidence: PCS. Frequency: 31/32. (PMID:29656860)
- Attention deficit hyperactivity disorder (HP:0007018): Attention deficit hyperactivity disorder (ADHD) manifests at age 2-3 years or by first grade at the latest. The main symptoms are distractibility, impulsivity, hyperactivity, and often trouble organizing tasks and projects, difficulty going to sleep, and social problems from being aggressive, loud, or impatient. Evidence: PCS. Frequency: 1/28. (PMID:29656860)
- Intellectual disability (HP:0001249): The term intellectual disability or intellectual developmental disorder is used to describe significantly sub-average intellectual and adaptive functioning based on clinical assessment and as measured by individually administered, appropriately normed, standardized and validated tests of intellectual functioning and adaptive behavior, with onset during the developmental period from infancy through adolescence. Evidence: PCS. Frequency: 23/23. (PMID:29656860)
- Autosomal dominant inheritance (HP:0000006): A mode of inheritance that is observed for traits related to a gene encoded on one of the autosomes (i.e., the human chromosomes 1-22) in which a trait manifests in heterozygotes. In the context of medical genetics, an autosomal dominant disorder is caused when a single copy of the mutant allele is present. Males and females are affected equally, and can both transmit the disorder with a risk of 50% for each child of inheriting the mutant allele. Evidence: PCS. (PMID:29656860)
These phenotypes are associated with the disease intellectual disability, autosomal dominant 50 (OMIM:617787).